- Deep philtrum (HP:0002002): Accentuated, prominent philtral ridges giving rise to an exaggerated groove in the midline between the nasal base and upper vermillion border. Evidence: TAS. Frequency: Frequent (HP:0040282). (ORPHA:77300)
- Intestinal malrotation (HP:0002566): An abnormality of the intestinal rotation and fixation that normally occurs during the development of the gut. This can lead to volvulus, or twisting of the intestine that causes obstruction and necrosis. Evidence: TAS. Frequency: Frequent (HP:0040282). (ORPHA:77300)
- Kyphosis (HP:0002808): Exaggerated anterior convexity of the thoracic vertebral column. Evidence: TAS. Frequency: Frequent (HP:0040282). (ORPHA:77300)
- Fundus hypopigmentation (HP:0007894): Generalized or focal reduced pigmentation of the fundus, evaluated in the context of skin and hair color. Fundoscopy may reveal a low level pigment. Evidence: TAS. Frequency: Frequent (HP:0040282). (ORPHA:77300)
- Increased nuchal translucency (HP:0010880): Nuchal translucency is the sonographic appearance of subcutaneous accumulation of liquid in the back of the fetal neck in the first trimester of pregnancy (11-14 gestational weeks of pregnancy). Evidence: TAS. Frequency: Frequent (HP:0040282). (ORPHA:77300)
- Periauricular skin pits (HP:0100277): Benign congenital lesions of the periauricular soft tissue consisting of a blind-ending narrow tube or pit. Evidence: TAS. Frequency: Frequent (HP:0040282). (ORPHA:77300)
- Orofacial cleft (HP:0000202): The presence of a cleft (gap, opening, or groove) in the oral cavity, including cleft of the upper lip and/or cleft of the palate. Cleft of the upper lip is visible as a groove or fissure in the lip, most frequently due to a congenital failure of the maxillary and median nasal processes to fuse. Cleft palate is characterized by a grooved depression or fissure in the roof of the mouth, most often resulting from a congenital failure of the palate to fuse properly. Clefts of the lip and palate can occur individually or together. It is preferable to code each defect separately. Evidence: TAS. Frequency: Very frequent (HP:0040281). (ORPHA:77300)
- Incomplete cleft of the upper lip (HP:0011340): Cleft of the upper lip that does not go all the way from the bottom of the upper lip until the nasal cavity. Evidence: TAS. Frequency: Very frequent (HP:0040281). (ORPHA:77300)
- Microcephaly (HP:0000252): Head circumference below 2 standard deviations below the mean for age and gender. Evidence: TAS. Frequency: Frequent (HP:0040282). (ORPHA:77300)
- Micrognathia (HP:0000347): Developmental hypoplasia of the mandible. Evidence: TAS. Frequency: Frequent (HP:0040282). (ORPHA:77300)
- Low-set ears (HP:0000369): Upper insertion of the ear to the scalp below an imaginary horizontal line drawn between the inner canthi of the eye and extending posteriorly to the ear. Evidence: TAS. Frequency: Frequent (HP:0040282). (ORPHA:77300)
- Abnormal pinna morphology (HP:0000377): An abnormality of the pinna, which is also referred to as the auricle or external ear. Evidence: TAS. Frequency: Frequent (HP:0040282). (ORPHA:77300)
- Underdeveloped nasal alae (HP:0000430): Thinned, deficient, or excessively arched ala nasi. Evidence: TAS. Frequency: Frequent (HP:0040282). (ORPHA:77300)
- Wide nasal bridge (HP:0000431): Increased breadth of the nasal bridge (and with it, the nasal root). Evidence: TAS. Frequency: Frequent (HP:0040282). (ORPHA:77300)
- Depressed nasal ridge (HP:0000457): Lack of prominence of the nose resulting from a posteriorly-placed nasal ridge. Evidence: TAS. Frequency: Frequent (HP:0040282). (ORPHA:77300)
- Myopia (HP:0000545): An abnormality of refraction characterized by the ability to see objects nearby clearly, while objects in the distance appear blurry. Evidence: TAS. Frequency: Frequent (HP:0040282). (ORPHA:77300)
- Visual loss (HP:0000572): Loss of visual acuity (implying that vision was better at a certain time point in life). Otherwise the term reduced visual acuity should be used (or a subclass of that). Evidence: TAS. Frequency: Frequent (HP:0040282). (ORPHA:77300)
- Abnormal optic nerve morphology (HP:0000587): Abnormality of the optic nerve. Evidence: TAS. Frequency: Frequent (HP:0040282). (ORPHA:77300)
- Nystagmus (HP:0000639): Rhythmic, involuntary oscillations of one or both eyes related to abnormality in fixation, conjugate gaze, or vestibular mechanisms. Evidence: TAS. Frequency: Frequent (HP:0040282). (ORPHA:77300)
- Pectus excavatum (HP:0000767): A defect of the chest wall characterized by a depression of the sternum, giving the chest ("pectus") a caved-in ("excavatum") appearance. Evidence: TAS. Frequency: Frequent (HP:0040282). (ORPHA:77300)
- Cervical ribs (HP:0000891). Evidence: TAS. Frequency: Frequent (HP:0040282). (ORPHA:77300)
- Plagiocephaly (HP:0001357): Asymmetric head shape, which is usually a combination of unilateral occipital flattening with ipsilateral frontal prominence, leading to rhomboid cranial shape. Evidence: TAS. Frequency: Frequent (HP:0040282). (ORPHA:77300)
These phenotypes are associated with the disease Auricular abnormalities-cleft lip with or without cleft palate-ocular abnormalities syndrome (ORPHA:77300).